Phenotypes associated with the disease intellectual developmental disorder with polymicrogyria and seizures (OMIM:621021):
- Bilateral tonic-clonic seizure (HP:0002069): A bilateral tonic-clonic seizure is a seizure defined by a tonic (bilateral increased tone, lasting seconds to minutes) and then a clonic (bilateral sustained rhythmic jerking) phase. Evidence: PCS. Frequency: 1/1. (PMID:39480921)
- Upslanted palpebral fissure (HP:0000582): The palpebral fissure inclination is more than two standard deviations above the mean for age (objective); or, the inclination of the palpebral fissure is greater than typical for age. Evidence: PCS. Frequency: 1/1. (PMID:39480921)
- Mild intellectual disability (HP:0001256): Mild intellectual disability (ID) is defined as a type of ID characterized by mildly sub-average adaptive functioning and intellectual functioning, with an intelligence quotient (IQ) the range of 50-69. Evidence: PCS. Frequency: 1/1. (PMID:39480921)
- Focal impaired awareness seizure (HP:0002384): Focal impaired awareness seizure (or focal seizure with impaired or lost awareness) is a type of focal-onset seizure characterized by some degree (which may be partial) of impairment of the person's awareness of themselves or their surroundings at any point during the seizure. Evidence: PCS. Frequency: 1/1. (PMID:39480921)
- Seizure (HP:0001250): A seizure is an intermittent abnormality of nervous system physiology characterized by a transient occurrence of signs and/or symptoms due to abnormal excessive or synchronous neuronal activity in the brain. Evidence: PCS. Frequency: 3/4. (PMID:39480921)
- Multifocal epileptiform discharges (HP:0010841): An abnormality in cerebral electrical activity recorded along the scalp by electroencephalography (EEG) and being identified at multiple locations (foci). Evidence: PCS. Frequency: 1/1. (PMID:39480921)
- Gray matter heterotopia (HP:0002282): Heterotopia or neuronal heterotopia are macroscopic clusters of misplaced neurons (gray matter), most often situated along the ventricular walls or within the subcortical white matter. Evidence: PCS. Frequency: 1/2. (PMID:39480921)
- Muscle fibrillation (HP:0010546): Fine, rapid twitching of individual muscle fibers with little or no movement of the muscle as a whole as ascertained by electromyography (EMG). If a motor neuron or its axon is destroyed, the muscle fibers it innervates undergo denervation atrophy. This leads to hypersensitivity of individual muscle fibers to acetyl choline so that they may contract spontaneously. Isolated activity of individual muscle fibers is generally so fine it cannot be seen through the intact skin, although it can be recorded as a short-duration spike in the EMG. Evidence: PCS. Frequency: 1/1. (PMID:39480921)
- Interictal epileptiform activity (HP:0011182): Epileptiform activity refers to distinctive EEG waves or complexes distinguished from background activity found in in a proportion of human subjects with epilepsy, but which can also be found in subjects without seizures. Interictal epileptiform activity refers to such activity that occurs in the absence of a clinical or subclinical seizure. Evidence: PCS. Frequency: 1/1. (PMID:39480921)
- Moderate global developmental delay (HP:0011343): A moderate delay in the achievement of motor or mental milestones in the domains of development of a child. Evidence: PCS. Frequency: 1/1. (PMID:39480921)
- Failure to thrive (HP:0001508): Failure to thrive (FTT) refers to a child whose physical growth is substantially below the norm. Evidence: PCS. Frequency: 1/1. (PMID:39480921)
- Smooth philtrum (HP:0000319): Flat skin surface, with no ridge formation in the central region of the upper lip between the nasal base and upper vermilion border. Evidence: PCS. Frequency: 1/1. (PMID:39480921)
- Pain insensitivity (HP:0007021): Inability to perceive painful stimuli. Evidence: PCS. Frequency: 1/1. (PMID:39480921)
- Periventricular heterotopia (HP:0007165): A form of gray matter heterotopia were the mislocalized gray matter is typically located periventricularly, also sometimes called subependymal heterotopia. Periventricular means beside the ventricles. This is by far the most common location for heterotopia. Subependymal heterotopia present in a wide array of variations. There can be a small single node or a large number of nodes, can exist on either or both sides of the brain at any point along the higher ventricle margins, can be small or large, single or multiple, and can form a small node or a large wavy or curved mass. Evidence: PCS. Frequency: 1/1. (PMID:39480921)
- Cow milk allergy (HP:0100327): Hypersensitivity in form of an adverse immune reaction against cow milk protein. Evidence: PCS. Frequency: 1/1. (PMID:39480921)
- Dental crowding (HP:0000678): Changes in alignment of teeth in the dental arch. Evidence: PCS. Frequency: 1/1. (PMID:39480921)
- Long palpebral fissure (HP:0000637): Distance between medial and lateral canthi is more than two standard deviations above the mean for age (objective); or, apparently increased length of the palpebral fissures. Evidence: PCS. Frequency: 1/1. (PMID:39480921)
- Ventriculomegaly (HP:0002119): An increase in size of the ventricular system of the brain. Evidence: PCS. Frequency: 1/2. (PMID:39480921)
- High palate (HP:0000218): Height of the palate more than 2 SD above the mean (objective) or palatal height at the level of the first permanent molar more than twice the height of the teeth (subjective). Evidence: PCS. Frequency: 1/1. (PMID:39480921)
- Hemiparesis (HP:0001269): Loss of strength in the arm, leg, and sometimes face on one side of the body. Hemiplegia refers to a complete loss of strength, whereas hemiparesis refers to an incomplete loss of strength. Evidence: PCS. Frequency: 1/1. (PMID:39480921)
- Macrocephaly (HP:0000256): Occipitofrontal (head) circumference greater than 97th centile compared to appropriate, age matched, sex-matched normal standards. Alternatively, a apparently increased size of the cranium. Evidence: PCS. Frequency: 1/4. (PMID:39480921)
- Intellectual disability (HP:0001249): The term intellectual disability or intellectual developmental disorder is used to describe significantly sub-average intellectual and adaptive functioning based on clinical assessment and as measured by individually administered, appropriately normed, standardized and validated tests of intellectual functioning and adaptive behavior, with onset during the developmental period from infancy through adolescence. Evidence: PCS. Frequency: 3/5. (PMID:39480921)
- Jaundice (HP:0000952): Yellow pigmentation of the skin due to bilirubin, which in turn is the result of increased bilirubin concentration in the bloodstream. Evidence: PCS. Frequency: 1/1. (PMID:39480921)
- Highly arched eyebrow (HP:0002553): Increased height of the central portion of the eyebrow, forming a crescent, semicircular, or inverted U shape. Evidence: PCS. Frequency: 1/1. (PMID:39480921)
- Microcephaly (HP:0000252): Head circumference below 2 standard deviations below the mean for age and gender. Evidence: PCS. Frequency: 2/3. (PMID:39480921)
- Bilateral perisylvian polymicrogyria (HP:0032407): A type of perisylvian polymicrogyria that affects both sides of the brain. Evidence: PCS. Frequency: 1/1. (PMID:39480921)
- Delayed speech and language development (HP:0000750): A degree of language development that is significantly below the norm for a child of a specified age. Evidence: PCS. Frequency: 1/1. (PMID:39480921)
- Global developmental delay (HP:0001263): A delay in the achievement of motor or mental milestones in the domains of development of a child, including motor skills, speech and language, cognitive skills, and social and emotional skills. This term should only be used to describe children younger than five years of age. Evidence: PCS. Frequency: 3/5. (PMID:39480921)
- Nocturnal seizures (HP:0031951): Seizures that occur while the affected individual is sleeping. Evidence: PCS. Frequency: 1/1. (PMID:39480921)
- Periorbital fullness (HP:0000629): Increase in periorbital soft tissue. Evidence: PCS. Frequency: 1/1. (PMID:39480921)
- Hyperintensity of cerebral white matter on MRI (HP:0030890): A brighter than expected signal on magnetic resonance imaging emanating from the cerebral white matter. Evidence: PCS. Frequency: 1/2. (PMID:39480921)
- Visual impairment (HP:0000505): Visual impairment (or vision impairment) is vision loss (of a person) to such a degree as to qualify as an additional support need through a significant limitation of visual capability resulting from either disease, trauma, or congenital or degenerative conditions that cannot be corrected by conventional means, such as refractive correction, medication, or surgery. Evidence: PCS. Frequency: 2/7. (PMID:39480921)
- Focal-onset seizure (HP:0007359): A focal-onset seizure is a type of seizure originating within networks limited to one hemisphere. They may be discretely localized or more widely distributed, and may originate in subcortical structures. Evidence: PCS. Frequency: 1/1. (PMID:39480921)
- Micrognathia (HP:0000347): Developmental hypoplasia of the mandible. Evidence: PCS. Frequency: 1/1. (PMID:39480921)
- Polymicrogyria (HP:0002126): Polymicrogyria is a congenital malformation of the cerebral cortex characterized by abnormal cortical layering (lamination) and an excessive number of small gyri (folds). Evidence: PCS. Frequency: 4/5. (PMID:39480921)
- Autosomal dominant inheritance (HP:0000006): A mode of inheritance that is observed for traits related to a gene encoded on one of the autosomes (i.e., the human chromosomes 1-22) in which a trait manifests in heterozygotes. In the context of medical genetics, an autosomal dominant disorder is caused when a single copy of the mutant allele is present. Males and females are affected equally, and can both transmit the disorder with a risk of 50% for each child of inheriting the mutant allele. Evidence: PCS. (PMID:39480921)